- Duodenal stenosis (HP:0100867): The narrowing or partial blockage of a portion of the duodenum. Evidence: IEA. (OMIM:167750)
- Annular pancreas (HP:0001734): A congenital anomaly in which the pancreas completely (or sometimes incompletely) encircles the second portion of duodenum and occasionally obstructs the more proximal duodenum. Evidence: IEA. (OMIM:167750)
- High intestinal obstruction (HP:0005250). Evidence: IEA. (OMIM:167750)
- Autosomal dominant inheritance (HP:0000006): A mode of inheritance that is observed for traits related to a gene encoded on one of the autosomes (i.e., the human chromosomes 1-22) in which a trait manifests in heterozygotes. In the context of medical genetics, an autosomal dominant disorder is caused when a single copy of the mutant allele is present. Males and females are affected equally, and can both transmit the disorder with a risk of 50% for each child of inheriting the mutant allele. Evidence: IEA. (OMIM:167750)
These phenotypes are associated with the disease annular pancreas (OMIM:167750).